- Epicanthus (HP:0000286): A fold of skin starting above the medial aspect of the upper eyelid and arching downward to cover, pass in front of and lateral to the medial canthus. Evidence: PCS. Frequency: 2/4. (PMID:30661772)
- Trigonocephaly (HP:0000243): Wedge-shaped, or triangular head, with the apex of the triangle at the midline of the forehead and the base of the triangle at the occiput. Evidence: PCS. Frequency: 1/4. (PMID:30661772)
- Anteverted nares (HP:0000463): Anteriorly-facing nostrils viewed with the head in the Frankfurt horizontal and the eyes of the observer level with the eyes of the subject. This gives the appearance of an upturned nose (upturned nasal tip). Evidence: PCS. Frequency: 3/4. (PMID:30661772)
- Exaggerated cupid's bow (HP:0002263): More pronounced paramedian peaks and median notch of the Cupid's bow. Evidence: PCS. Frequency: 4/4. (PMID:30661772)
- Cerebellar atrophy (HP:0001272): Cerebellar atrophy is defined as a cerebellum with initially normal structures, in a posterior fossa with normal size, which displays enlarged fissures (interfolial spaces) in comparison to the foliae secondary to loss of tissue. Cerebellar atrophy implies irreversible loss of tissue and result from an ongoing progressive disease until a final stage is reached or a single injury, e.g. an intoxication or infectious event. Evidence: PCS. Frequency: 1/4. (PMID:30661772)
- Short nose (HP:0003196): Distance from nasion to subnasale more than two standard deviations below the mean, or alternatively, an apparently decreased length from the nasal root to the nasal tip. Evidence: PCS. Frequency: 1/4. (PMID:30661772)
- Generalized hypotonia (HP:0001290): Generalized muscular hypotonia (abnormally low muscle tone). Evidence: PCS. Frequency: 1/4. (PMID:30661772)
- Ventricular septal defect (HP:0001629): A hole between the two bottom chambers (ventricles) of the heart. The defect is centered around the most superior aspect of the ventricular septum. Evidence: PCS. Frequency: 1/4. (PMID:30661772)
- Thick vermilion border (HP:0012471): Increased width of the skin of vermilion border region of upper lip. Evidence: PCS. Frequency: 2/4. (PMID:30661772)
- Delayed eruption of permanent teeth (HP:0000696): Delayed tooth eruption affecting the secondary dentition. Evidence: PCS. Frequency: 1/4. (PMID:30661772)
- Posteriorly rotated ears (HP:0000358): A type of abnormal location of the ears in which the position of the ears is characterized by posterior rotation (the superior part of the ears is rotated towards the back of the head, and the inferior part of the ears towards the front). Evidence: PCS. Frequency: 2/4. (PMID:30661772)
- Laryngomalacia (HP:0001601): Laryngomalacia is a congenital abnormality of the laryngeal cartilage in which the cartilage is floppy and prolapses over the larynx during inspiration. Evidence: PCS. Frequency: 1/4. (PMID:30661772)
- Intellectual disability (HP:0001249): The term intellectual disability or intellectual developmental disorder is used to describe significantly sub-average intellectual and adaptive functioning based on clinical assessment and as measured by individually administered, appropriately normed, standardized and validated tests of intellectual functioning and adaptive behavior, with onset during the developmental period from infancy through adolescence. Evidence: PCS. Frequency: 4/4. (PMID:30661772)
- Wide mouth (HP:0000154): Distance between the oral commissures more than 2 SD above the mean. Alternatively, an apparently increased width of the oral aperture (subjective). Evidence: PCS. Frequency: 4/4. (PMID:30661772)
- Axial hypotonia (HP:0008936): Muscular hypotonia (abnormally low muscle tone) affecting the musculature of the trunk. Evidence: PCS. Frequency: 1/4. (PMID:30661772)
- Microcephaly (HP:0000252): Head circumference below 2 standard deviations below the mean for age and gender. Evidence: PCS. Frequency: 2/4. (PMID:30661772)
- Delayed speech and language development (HP:0000750): A degree of language development that is significantly below the norm for a child of a specified age. Evidence: PCS. Frequency: 4/4. (PMID:30661772)
- Delayed ability to walk (HP:0031936): A failure to achieve the ability to walk at an appropriate developmental stage. Most children learn to walk in a series of stages, and learn to walk short distances independently between 12 and 15 months. Evidence: PCS. Frequency: 3/4. (PMID:30661772)
- Feeding difficulties (HP:0011968): Impaired ability to eat related to problems gathering food and getting ready to suck, chew, or swallow it. Evidence: PCS. Frequency: 2/4. (PMID:30661772)
- Spastic tetraparesis (HP:0001285): Spastic weakness affecting all four limbs. Evidence: PCS. Frequency: 1/4. (PMID:30661772)
- Global developmental delay (HP:0001263): A delay in the achievement of motor or mental milestones in the domains of development of a child, including motor skills, speech and language, cognitive skills, and social and emotional skills. This term should only be used to describe children younger than five years of age. Evidence: PCS. Frequency: 4/4. (PMID:30661772)
- Infra-orbital crease (HP:0100876): Skin crease extending from below the inner canthus laterally along the malar process of the maxilla and zygoma. Evidence: PCS. Frequency: 3/4. (PMID:30661772)
- Rocker bottom foot (HP:0001838): The presence of both a prominent heel and a convex contour of the sole. Evidence: PCS. Frequency: 1/4. (PMID:30661772)
- Clinodactyly of the 5th finger (HP:0004209): Clinodactyly refers to a bending or curvature of the fifth finger in the radial direction (i.e., towards the 4th finger). Evidence: PCS. Frequency: 4/4. (PMID:30661772)
- Low-set ears (HP:0000369): Upper insertion of the ear to the scalp below an imaginary horizontal line drawn between the inner canthi of the eye and extending posteriorly to the ear. Evidence: PCS. Frequency: 1/4. (PMID:30661772)
- Autosomal dominant inheritance (HP:0000006): A mode of inheritance that is observed for traits related to a gene encoded on one of the autosomes (i.e., the human chromosomes 1-22) in which a trait manifests in heterozygotes. In the context of medical genetics, an autosomal dominant disorder is caused when a single copy of the mutant allele is present. Males and females are affected equally, and can both transmit the disorder with a risk of 50% for each child of inheriting the mutant allele. Evidence: PCS. (PMID:30661772)
These phenotypes are associated with the disease Coffin-Siris syndrome 10 (OMIM:618506).